Phenotypes associated with the disease odontomicronychial dysplasia (OMIM:601319):
- Slow-growing nails (HP:0008383): Nails whose growth is slower than normal. Evidence: PCS. (OMIM:601319)
- Thin nail (HP:0001816): Nail that appears thin when viewed on end. Evidence: PCS. (OMIM:601319)
- Autosomal recessive inheritance (HP:0000007): A mode of inheritance that is observed for traits related to a gene encoded on one of the autosomes (i.e., the human chromosomes 1-22) in which a trait manifests in individuals with two pathogenic alleles, either homozygotes (two copies of the same mutant allele) or compound heterozygotes (whereby each copy of a gene has a distinct mutant allele). Evidence: IEA. (OMIM:601319)
- Premature eruption of permanent teeth (HP:0006337): Premature tooth eruption of the permanent dentition. Evidence: IEA. (OMIM:601319)
- Short nail (HP:0001799): Decreased length of nail. Evidence: PCS. (OMIM:601319)